Phenotypes associated with the disease Incontinentia pigmenti (ORPHA:464):
- Orofacial cleft (HP:0000202): The presence of a cleft (gap, opening, or groove) in the oral cavity, including cleft of the upper lip and/or cleft of the palate. Cleft of the upper lip is visible as a groove or fissure in the lip, most frequently due to a congenital failure of the maxillary and median nasal processes to fuse. Cleft palate is characterized by a grooved depression or fissure in the roof of the mouth, most often resulting from a congenital failure of the palate to fuse properly. Clefts of the lip and palate can occur individually or together. It is preferable to code each defect separately. Evidence: TAS. Frequency: Frequent (HP:0040282). (ORPHA:464)
- Hearing abnormality (HP:0000364): An abnormality of the sensory perception of sound. Evidence: TAS. Frequency: Frequent (HP:0040282). (ORPHA:464)
- Strabismus (HP:0000486): A misalignment of the eyes so that the visual axes deviate from bifoveal fixation. The classification of strabismus may be based on a number of features including the relative position of the eyes, whether the deviation is latent or manifest, intermittent or constant, concomitant or otherwise and according to the age of onset and the relevance of any associated refractive error. Evidence: TAS. Frequency: Frequent (HP:0040282). (ORPHA:464)
- Keratitis (HP:0000491): Inflammation of the cornea. Evidence: TAS. Frequency: Occasional (HP:0040283). (ORPHA:464)
- Visual impairment (HP:0000505): Visual impairment (or vision impairment) is vision loss (of a person) to such a degree as to qualify as an additional support need through a significant limitation of visual capability resulting from either disease, trauma, or congenital or degenerative conditions that cannot be corrected by conventional means, such as refractive correction, medication, or surgery. Evidence: TAS. Frequency: Frequent (HP:0040282). (ORPHA:464)
- Cataract (HP:0000518): A cataract is an opacity or clouding that develops in the crystalline lens of the eye or in its capsule. Evidence: TAS. Frequency: Occasional (HP:0040283). (ORPHA:464)
- Abnormal chorioretinal morphology (HP:0000532): An abnormality of the choroid and retina. Evidence: TAS. Frequency: Occasional (HP:0040283). (ORPHA:464)
- Retinal detachment (HP:0000541): Separation of the inner layers of the retina (neural retina) from the pigment epithelium. Evidence: TAS. Frequency: Occasional (HP:0040283). (ORPHA:464)
- Uveitis (HP:0000554): Inflammation of one or all portions of the uveal tract. Evidence: TAS. Frequency: Occasional (HP:0040283). (ORPHA:464)
- Microphthalmia (HP:0000568): A developmental anomaly characterized by abnormal smallness of one or both eyes. Evidence: TAS. Frequency: Occasional (HP:0040283). (ORPHA:464)
- Retinal hemorrhage (HP:0000573): Bleeding located within the retina. Retinal hemorrhages range from the smallest dot and blot hemorrhage to massive sub-hyaloid hemorrhage. Evidence: TAS. Frequency: Occasional (HP:0040283). (ORPHA:464)
- Blue sclerae (HP:0000592): An abnormal bluish coloration of the sclera. Evidence: TAS. Frequency: Occasional (HP:0040283). (ORPHA:464)
- Hypodontia (HP:0000668): The absence of five or less teeth from the normal series by a failure to develop. Evidence: TAS. Frequency: Very frequent (HP:0040281). (ORPHA:464)
- Abnormal dental enamel morphology (HP:0000682): An abnormality of the dental enamel. Evidence: TAS. Frequency: Occasional (HP:0040283). (ORPHA:464)
- Delayed eruption of teeth (HP:0000684): Delayed tooth eruption, which can be defined as tooth eruption more than 2 SD beyond the mean eruption age. Evidence: TAS. Frequency: Frequent (HP:0040282). (ORPHA:464)
- Hyperkeratosis (HP:0000962): Hyperkeratosis is a histopathological term defining a thickened stratum corneum and may be present in many different skin conditions, with many possible overlaps. Hyperkeratosis refers to the increased thickness of the stratum corneum, the outer layer of the skin. Hyperkeratosis is subclassified as orthokeratotic or parakeratotic. Orthokeratotic hyperkeratosis refers to the thickening of the keratin layer with preserved keratinocyte maturation, while parakeratotic hyperkeratosis shows retained nuclei as a sign of delayed maturation of keratinocytes. Evidence: TAS. Frequency: Frequent (HP:0040282). (ORPHA:464)
- Hyperhidrosis (HP:0000975): Abnormal excessive perspiration (sweating) despite the lack of appropriate stimuli like hot and humid weather. Evidence: TAS. Frequency: Frequent (HP:0040282). (ORPHA:464)
- Skin rash (HP:0000988): A red eruption of the skin. Evidence: TAS. Frequency: Very frequent (HP:0040281). (ORPHA:464)
- Abnormal skin pigmentation (HP:0001000): An abnormality of the pigmentation of the skin. Evidence: TAS. Frequency: Very frequent (HP:0040281). (ORPHA:464)
- Hypopigmented skin patches (HP:0001053). Evidence: TAS. Frequency: Very frequent (HP:0040281). (ORPHA:464)
- Abnormal fingernail morphology (HP:0001231): An abnormality of the fingernails. Evidence: TAS. Frequency: Very frequent (HP:0040281). (ORPHA:464)
- Intellectual disability (HP:0001249): The term intellectual disability or intellectual developmental disorder is used to describe significantly sub-average intellectual and adaptive functioning based on clinical assessment and as measured by individually administered, appropriately normed, standardized and validated tests of intellectual functioning and adaptive behavior, with onset during the developmental period from infancy through adolescence. Evidence: TAS. Frequency: Occasional (HP:0040283). (ORPHA:464)
- Seizure (HP:0001250): A seizure is an intermittent abnormality of nervous system physiology characterized by a transient occurrence of signs and/or symptoms due to abnormal excessive or synchronous neuronal activity in the brain. Evidence: TAS. Frequency: Occasional (HP:0040283). (ORPHA:464)
- Hypotonia (HP:0001252): Hypotonia is an abnormally low muscle tone (the amount of tension or resistance to movement in a muscle). Even when relaxed, muscles have a continuous and passive partial contraction which provides some resistance to passive stretching. Hypotonia thus manifests as diminished resistance to passive stretching. Hypotonia is not the same as muscle weakness, although the two conditions can co-exist. Evidence: TAS. Frequency: Occasional (HP:0040283). (ORPHA:464)
- Spasticity (HP:0001257): A motor disorder characterized by a velocity-dependent increase in tonic stretch reflexes with increased muscle tone, exaggerated (hyperexcitable) tendon reflexes. Evidence: TAS. Frequency: Occasional (HP:0040283). (ORPHA:464)
- Global developmental delay (HP:0001263): A delay in the achievement of motor or mental milestones in the domains of development of a child, including motor skills, speech and language, cognitive skills, and social and emotional skills. This term should only be used to describe children younger than five years of age. Evidence: TAS. Frequency: Occasional (HP:0040283). (ORPHA:464)
- Gait disturbance (HP:0001288): The term gait disturbance can refer to any disruption of the ability to walk. Evidence: TAS. Frequency: Frequent (HP:0040282). (ORPHA:464)
- Umbilical hernia (HP:0001537): Protrusion of abdominal contents through a defect in the abdominal wall musculature around the umbilicus. Skin and subcutaneous tissue overlie the defect. Evidence: TAS. Frequency: Occasional (HP:0040283). (ORPHA:464)
- Abnormal hair morphology (HP:0001595): An abnormality of the hair. Evidence: TAS. Frequency: Very frequent (HP:0040281). (ORPHA:464)
- Alopecia (HP:0001596): A noncongenital process of hair loss, which may progress to partial or complete baldness. Evidence: TAS. Frequency: Frequent (HP:0040282). (ORPHA:464)
- Abnormal nail morphology (HP:0001597): Abnormal structure or appearance of the nail. Evidence: TAS. Frequency: Very frequent (HP:0040281). (ORPHA:464)
- Congestive heart failure (HP:0001635): The presence of an abnormality of cardiac function that is responsible for the failure of the heart to pump blood at a rate that is commensurate with the needs of the tissues or a state in which abnormally elevated filling pressures are required for the heart to do so. Heart failure is frequently related to a defect in myocardial contraction. Evidence: TAS. Frequency: Occasional (HP:0040283). (ORPHA:464)
- Hypoplastic fingernail (HP:0001804): Underdevelopment of a fingernail. Evidence: TAS. Frequency: Very frequent (HP:0040281). (ORPHA:464)
- Dystrophic toenail (HP:0001810): Toenail changes apart from changes of the color of the toenail (nail dyschromia) that involve partial or complete disruption of the various keratinous layers of the nail plate. Evidence: TAS. Frequency: Occasional (HP:0040283). (ORPHA:464)
- Broad nail (HP:0001821): Increased width of nail. Evidence: TAS. Frequency: Occasional (HP:0040283). (ORPHA:464)
- Increased total eosinophil count (HP:0001880): Increased count of eosinophils in the blood. Evidence: TAS. Frequency: Frequent (HP:0040282). (ORPHA:464)
- Pulmonary arterial hypertension (HP:0002092): Pulmonary hypertension is defined mean pulmonary artery pressure of 25mmHg or more and pulmonary capillary wedge pressure of 15mmHg or less when measured by right heart catheterisation at rest and in a supine position. Evidence: TAS. Frequency: Occasional (HP:0040283). (ORPHA:464)
- Cerebral cortical atrophy (HP:0002120): Atrophy of the cortex of the cerebrum. Evidence: TAS. Frequency: Occasional (HP:0040283). (ORPHA:464)
- Infectious encephalitis (HP:0002383): A disorder of the brain caused by an infectious agent that presents with fever, headache, and an altered level of consciousness. There may also be focal or multifocal neurologic deficits, and focal or generalized seizure activity. Evidence: TAS. Frequency: Occasional (HP:0040283). (ORPHA:464)
- Supernumerary nipple (HP:0002558): Presence of more than two nipples. Evidence: TAS. Frequency: Frequent (HP:0040282). (ORPHA:464)
- Cerebral ischemia (HP:0002637): Restriction of arterial blood supply to the brain associated with insufficient oxygenation to support the metabolic requirements of the tissue. Evidence: TAS. Frequency: Occasional (HP:0040283). (ORPHA:464)
- Scoliosis (HP:0002650): The presence of an abnormal lateral curvature of the spine. Evidence: TAS. Frequency: Frequent (HP:0040282). (ORPHA:464)
- Osteolysis (HP:0002797): Osteolysis refers to the destruction of bone through bone resorption with removal or loss of calcium. Evidence: TAS. Frequency: Frequent (HP:0040282). (ORPHA:464)
- Spina bifida occulta (HP:0003298): The closed form of spina bifida with incomplete closure of a vertebral body with intact overlying skin. Evidence: TAS. Frequency: Occasional (HP:0040283). (ORPHA:464)
- Absent hand (HP:0004050): The total absence of the hand, with no bony elements distal to the radius or ulna. Evidence: TAS. Frequency: Occasional (HP:0040283). (ORPHA:464)
- Deviation of finger (HP:0004097): Deviated fingers is a term that should be used if one or more fingers of the hand are deviated from their normal position, either to the radial or ulnar side. A deviation of a finger can be caused by an abnormal form of one or more of the phalanges of the affected finger, or by a deviation or displacement of one or more phalanges. Evidence: TAS. Frequency: Frequent (HP:0040282). (ORPHA:464)
- Short stature (HP:0004322): A height below that which is expected according to age and gender norms. Although there is no universally accepted definition of short stature, many refer to "short stature" as height more than 2 standard deviations below the mean for age and gender (or below the 3rd percentile for age and gender dependent norms). Evidence: TAS. Frequency: Frequent (HP:0040282). (ORPHA:464)
- Hemiplegia/hemiparesis (HP:0004374): Loss of strength in the arm, leg, and sometimes face on one side of the body. Hemiplegia refers to a severe or complete loss of strength, whereas hemiparesis refers to a relatively mild loss of strength. Evidence: TAS. Frequency: Occasional (HP:0040283). (ORPHA:464)
- Supernumerary ribs (HP:0005815): The presence of more than 12 rib pairs. Evidence: TAS. Frequency: Frequent (HP:0040282). (ORPHA:464)
- Abnormal hand morphology (HP:0005922): Any structural anomaly of the hand. Evidence: TAS. Frequency: Frequent (HP:0040282). (ORPHA:464)
- Finger syndactyly (HP:0006101): Webbing or fusion of the fingers, involving soft parts only or including bone structure. Bony fusions are referred to as "bony" Syndactyly if the fusion occurs in a radio-ulnar axis. Fusions of bones of the fingers in a proximo-distal axis are referred to as "Symphalangism". Evidence: TAS. Frequency: Occasional (HP:0040283). (ORPHA:464)
- Abnormal dental morphology (HP:0006482): An abnormality of the morphology of the tooth. Evidence: TAS. Frequency: Frequent (HP:0040282). (ORPHA:464)
- Attention deficit hyperactivity disorder (HP:0007018): Attention deficit hyperactivity disorder (ADHD) manifests at age 2-3 years or by first grade at the latest. The main symptoms are distractibility, impulsivity, hyperactivity, and often trouble organizing tasks and projects, difficulty going to sleep, and social problems from being aggressive, loud, or impatient. Evidence: TAS. Frequency: Frequent (HP:0040282). (ORPHA:464)
- Irregular hyperpigmentation (HP:0007400). Evidence: TAS. Frequency: Very frequent (HP:0040281). (ORPHA:464)
- Retinal neovascularization (HP:0030666): In ischemic retinal disease, neovascularization (NV) involves the sprouting of new vessels from pre-existent vessels. Ischemia invariably leads to the upregulation of Vascular Endothelial Growth Factor (VEGF) production. Most frequently the new vessels grow internal to the plane of the retina. However, intraretinal proliferation of new vessels can also occur. Evidence: TAS. Frequency: Occasional (HP:0040283). (ORPHA:464)
- Corneal opacity (HP:0007957): A reduction of corneal clarity. Evidence: TAS. Frequency: Frequent (HP:0040282). (ORPHA:464)
- Abnormal blistering of the skin (HP:0008066): The presence of one or more bullae on the skin, defined as fluid-filled blisters more than 5 mm in diameter with thin walls. Evidence: TAS. Frequency: Very frequent (HP:0040281). (ORPHA:464)
- Abnormal toenail morphology (HP:0008388): An anomaly of the toenail. Evidence: TAS. Frequency: Occasional (HP:0040283). (ORPHA:464)
- Ridged fingernail (HP:0008402): Longitudinal, linear prominences in the fingernail plate. Evidence: TAS. Frequency: Occasional (HP:0040283). (ORPHA:464)
- Erythema (HP:0010783): Redness of the skin, caused by hyperemia of the capillaries in the lower layers of the skin. Evidence: TAS. Frequency: Very frequent (HP:0040281). (ORPHA:464)
- Abnormality of immune system physiology (HP:0010978): A functional abnormality of the immune system. Evidence: TAS. Frequency: Frequent (HP:0040282). (ORPHA:464)
- Camptodactyly of finger (HP:0100490): The distal interphalangeal joint and/or the proximal interphalangeal joint of the fingers cannot be extended to 180 degrees by either active or passive extension. Evidence: TAS. Frequency: Frequent (HP:0040282). (ORPHA:464)
- Cognitive impairment (HP:0100543): Abnormal cognition is characterized by deficits in thinking, reasoning, or remembering. Evidence: TAS. Frequency: Occasional (HP:0040283). (ORPHA:464)
- Asymmetric growth (HP:0100555): A growth pattern that displays an abnormal difference between the left and the right side. Evidence: TAS. Frequency: Frequent (HP:0040282). (ORPHA:464)
- Telangiectasia of the skin (HP:0100585): Presence of small, permanently dilated blood vessels near the surface of the skin, visible as small focal red lesions. Evidence: TAS. Frequency: Very frequent (HP:0040281). (ORPHA:464)
- Skin ulcer (HP:0200042): A discontinuity of the skin exhibiting complete loss of the epidermis and often portions of the dermis and even subcutaneous fat. Evidence: TAS. Frequency: Frequent (HP:0040282). (ORPHA:464)
- Verrucae (HP:0200043): Warts, benign growths on the skin or mucous membranes that cause cosmetic problems as well as pain and discomfort. Warts most often occur on the hands, feet, and genital areas. Evidence: TAS. Frequency: Very frequent (HP:0040281). (ORPHA:464)